- Congenital, generalized hypertrichosis (HP:0004540): A confluent, generalized overgrowth of silvery blonde to gray lanugo hair at birth. Evidence: TAS. (OMIM:145701)
- Autosomal dominant inheritance (HP:0000006): A mode of inheritance that is observed for traits related to a gene encoded on one of the autosomes (i.e., the human chromosomes 1-22) in which a trait manifests in heterozygotes. In the context of medical genetics, an autosomal dominant disorder is caused when a single copy of the mutant allele is present. Males and females are affected equally, and can both transmit the disorder with a risk of 50% for each child of inheriting the mutant allele. Evidence: IEA. (OMIM:145701)
These phenotypes are associated with the disease Ambras type hypertrichosis universalis congenita (OMIM:145701).